- Joint stiffness (HP:0001387): Joint stiffness is a perceived sensation of tightness in a joint or joints when attempting to move them after a period of inactivity. Joint stiffness typically subsides over time. Evidence: TAS. Frequency: Frequent (HP:0040282). (ORPHA:564003)
- Arthralgia (HP:0002829): Joint pain. Evidence: TAS. Frequency: Frequent (HP:0040282). (ORPHA:564003)
- Progressive joint destruction (HP:0005187). Evidence: TAS. Frequency: Frequent (HP:0040282). (ORPHA:564003)
- Flattened metatarsal heads (HP:0005194): Abnormally flat shape of the heads of the metatarsal bones. Evidence: TAS. Frequency: Frequent (HP:0040282). (ORPHA:564003)
- Structural foot deformity (HP:0010219): A foot deformity resulting due to an abnormality affecting the bones of the foot (as well as muscle and soft tissue). In contrast if only the muscle and soft tissue are affected the term positional foot deformity applies. Evidence: TAS. Frequency: Frequent (HP:0040282). (ORPHA:564003)
- Abnormal metatarsal epiphysis morphology (HP:0010630): Any abnormality of a metatarsal bone epiphysis. Evidence: TAS. Frequency: Frequent (HP:0040282). (ORPHA:564003)
- Pedal edema (HP:0010741): An abnormal accumulation of excess fluid in the lower extremity resulting in swelling of the feet and extending upward to the lower leg. Evidence: TAS. Frequency: Frequent (HP:0040282). (ORPHA:564003)
- Foot pain (HP:0025238): An unpleasant sensation characterized by physical discomfort (such as pricking, throbbing, or aching) localized to the foot. Evidence: TAS. Frequency: Frequent (HP:0040282). (ORPHA:564003)
- Abnormality of the second metatarsal bone (HP:0040034). Evidence: TAS. Frequency: Frequent (HP:0040282). (ORPHA:564003)
- Osteochondrosis (HP:0040188): Abnormal growth ossification centers in children. Initially a degeneration/ necrosis followed by regeneration or recalcification. Evidence: TAS. Frequency: Frequent (HP:0040282). (ORPHA:564003)
- Thickened cortex of bones (HP:0100039): An Abnormality of cortical bone leading to an abnormal thickness of the cortex of affected bones. Evidence: TAS. Frequency: Frequent (HP:0040282). (ORPHA:564003)
- Chondritis (HP:0100662): Inflammation of cartilage. Evidence: TAS. Frequency: Frequent (HP:0040282). (ORPHA:564003)
- Sclerosis of foot bone (HP:0100925): An elevation in bone density in one or more foot bones. Sclerosis is normally detected on a radiograph as an area of increased opacity. Evidence: TAS. Frequency: Frequent (HP:0040282). (ORPHA:564003)
- Abnormality of the third metatarsal bone (HP:0010672): An abnormality of the third metatarsal bone. Evidence: TAS. Frequency: Occasional (HP:0040283). (ORPHA:564003)
- Avascular necrosis (HP:0010885): A disease where there is cellular death (necrosis) of bone components due to interruption of the blood supply. Evidence: TAS. Frequency: Occasional (HP:0040283). (ORPHA:564003)
- Abnormality of the fifth metatarsal bone (HP:0008089): An anomaly of the fifth metatarsal bone. Evidence: TAS. Frequency: Very rare (HP:0040284). (ORPHA:564003)
- Abnormality of the fourth metatarsal bone (HP:0040035). Evidence: TAS. Frequency: Very rare (HP:0040284). (ORPHA:564003)
- Gait disturbance (HP:0001288): The term gait disturbance can refer to any disruption of the ability to walk. Evidence: TAS. Frequency: Frequent (HP:0040282). (ORPHA:564003)
- Arthritis (HP:0001369): Inflammation of a joint. Evidence: TAS. Frequency: Frequent (HP:0040282). (ORPHA:564003)
These phenotypes are associated with the disease Osteochondrosis of the metatarsal bone (ORPHA:564003).